- Epicanthus (HP:0000286): A fold of skin starting above the medial aspect of the upper eyelid and arching downward to cover, pass in front of and lateral to the medial canthus. Evidence: IEA. (OMIM:618056)
- Hypertonia (HP:0001276): A condition in which there is increased muscle tone so that arms or legs, for example, are stiff and difficult to move. Evidence: IEA. (OMIM:618056)
- Exaggerated startle response (HP:0002267): An exaggerated startle reaction in response to a sudden unexpected visual or acoustic stimulus, or a quick movement near the face. Evidence: PCS. Frequency: 1/1. (PMID:26483087)
- Tented upper lip vermilion (HP:0010804): Triangular appearance of the oral aperture with the apex in the midpoint of the upper vermilion and the lower vermilion forming the base. Evidence: IEA. (OMIM:618056)
- Long philtrum (HP:0000343): Distance between nasal base and midline upper lip vermilion border more than 2 SD above the mean. Alternatively, an apparently increased distance between nasal base and midline upper lip vermilion border. Evidence: IEA. (OMIM:618056)
- Dysmetria (HP:0001310): A type of ataxia characterized by the inability to carry out movements with the correct range and motion across the plane of more than one joint related to incorrect estimation of the distances required for targeted movements. Evidence: IEA. (OMIM:618056)
- Cerebellar atrophy (HP:0001272): Cerebellar atrophy is defined as a cerebellum with initially normal structures, in a posterior fossa with normal size, which displays enlarged fissures (interfolial spaces) in comparison to the foliae secondary to loss of tissue. Cerebellar atrophy implies irreversible loss of tissue and result from an ongoing progressive disease until a final stage is reached or a single injury, e.g. an intoxication or infectious event. Evidence: PCS. Frequency: 1/1. (PMID:26483087)
- Seizure (HP:0001250): A seizure is an intermittent abnormality of nervous system physiology characterized by a transient occurrence of signs and/or symptoms due to abnormal excessive or synchronous neuronal activity in the brain. Evidence: IEA. (OMIM:618056)
- Focal impaired awareness seizure (HP:0002384): Focal impaired awareness seizure (or focal seizure with impaired or lost awareness) is a type of focal-onset seizure characterized by some degree (which may be partial) of impairment of the person's awareness of themselves or their surroundings at any point during the seizure. Evidence: PCS. Frequency: 1/1. (PMID:26483087)
- Gait ataxia (HP:0002066): A type of ataxia characterized by the impairment of the ability to coordinate the movements required for normal walking. Gait ataxia is characteirzed by a wide-based staggering gait with a tendency to fall. Evidence: IEA. (OMIM:618056)
- Broad face (HP:0000283): Bizygomatic (upper face) and bigonial (lower face) width greater than 2 standard deviations above the mean (objective); or an apparent increase in the width of the face (subjective). Evidence: IEA. (OMIM:618056)
- Infantile onset (HP:0003593): Onset of signs or symptoms of disease between 28 days to one year of life. Evidence: PCS. Frequency: 1/1. (PMID:26483087)
- Horizontal jerk nystagmus (HP:0007286): Nystagmus consisting of horizontal to-and-fro eye movements, in which the movement in one direction is faster than in the other. Evidence: PCS. Frequency: 1/1. (PMID:26483087)
- Agitation (HP:0000713): A state of excessive motor activity that is associated with mental distress or a feeling of substantial unease or inner tension. Distinguished from restlessness by the increased level of emotional distress and negative intensity of the experience. Agitation has a significant level of physical activity that is typically threatening to the self or others. Evidence: IEA. (OMIM:618056)
- High palate (HP:0000218): Height of the palate more than 2 SD above the mean (objective) or palatal height at the level of the first permanent molar more than twice the height of the teeth (subjective). Evidence: IEA. (OMIM:618056)
- Intellectual disability (HP:0001249): The term intellectual disability or intellectual developmental disorder is used to describe significantly sub-average intellectual and adaptive functioning based on clinical assessment and as measured by individually administered, appropriately normed, standardized and validated tests of intellectual functioning and adaptive behavior, with onset during the developmental period from infancy through adolescence. Evidence: IEA. (OMIM:618056)
- Hyperreflexia (HP:0001347): Hyperreflexia is the presence of hyperactive stretch reflexes of the muscles. Evidence: PCS. Frequency: 1/1. (PMID:26483087)
- Axial hypotonia (HP:0008936): Muscular hypotonia (abnormally low muscle tone) affecting the musculature of the trunk. Evidence: PCS. Frequency: 1/1. (PMID:26483087)
- Absent speech (HP:0001344): Complete lack of development of speech and language abilities. Evidence: IEA. (OMIM:618056)
- Delayed speech and language development (HP:0000750): A degree of language development that is significantly below the norm for a child of a specified age. Evidence: IEA. (OMIM:618056)
- Thin vermilion border (HP:0000233): Height of the vermilion of the medial part of the lip more than 2 SD below the mean, or apparently reduced height of the vermilion of the lip in the frontal view. The vermilion is the red part of the lips (and confusingly, the vermilion itself is also often referred to as being equivalent the lips). Evidence: IEA. (OMIM:618056)
- Delayed ability to walk (HP:0031936): A failure to achieve the ability to walk at an appropriate developmental stage. Most children learn to walk in a series of stages, and learn to walk short distances independently between 12 and 15 months. Evidence: IEA. (OMIM:618056)
- Hypoplasia of the corpus callosum (HP:0002079): Underdevelopment of the corpus callosum. Evidence: IEA. (OMIM:618056)
- Truncal titubation (HP:0030147): Tremor of the trunk in an anterior-posterior plane at 3-4 Hz. Evidence: IEA. (OMIM:618056)
- Feeding difficulties (HP:0011968): Impaired ability to eat related to problems gathering food and getting ready to suck, chew, or swallow it. Evidence: IEA. (OMIM:618056)
- Global developmental delay (HP:0001263): A delay in the achievement of motor or mental milestones in the domains of development of a child, including motor skills, speech and language, cognitive skills, and social and emotional skills. This term should only be used to describe children younger than five years of age. Evidence: PCS. Frequency: 1/1. (PMID:26483087)
- Secondary microcephaly (HP:0005484): Head circumference which falls below 2 standard deviations below the mean for age and gender because of insufficient head growth after birth. Evidence: PCS. Frequency: 1/1. (PMID:26483087)
- Limb hypertonia (HP:0002509). Evidence: PCS. Frequency: 1/1. (PMID:26483087)
- Abnormal cerebellum morphology (HP:0001317): Any structural abnormality of the cerebellum. Evidence: IEA. (OMIM:618056)
- Autosomal recessive inheritance (HP:0000007): A mode of inheritance that is observed for traits related to a gene encoded on one of the autosomes (i.e., the human chromosomes 1-22) in which a trait manifests in individuals with two pathogenic alleles, either homozygotes (two copies of the same mutant allele) or compound heterozygotes (whereby each copy of a gene has a distinct mutant allele). Evidence: PCS. (PMID:26483087)
- Visual impairment (HP:0000505): Visual impairment (or vision impairment) is vision loss (of a person) to such a degree as to qualify as an additional support need through a significant limitation of visual capability resulting from either disease, trauma, or congenital or degenerative conditions that cannot be corrected by conventional means, such as refractive correction, medication, or surgery. Evidence: IEA. Frequency: Very rare (HP:0040284). (OMIM:618056)
- Clinodactyly of the 5th finger (HP:0004209): Clinodactyly refers to a bending or curvature of the fifth finger in the radial direction (i.e., towards the 4th finger). Evidence: IEA. (OMIM:618056)
- Apnea (HP:0002104): Lack of breathing with no movement of the respiratory muscles and no exchange of air in the lungs. This term refers to a disposition to have recurrent episodes of apnea rather than to a single event. Evidence: IEA. (OMIM:618056)
- Tremor (HP:0001337): An unintentional, oscillating to-and-fro muscle movement about a joint axis. Evidence: IEA. (OMIM:618056)
These phenotypes are associated with the disease neurodevelopmental disorder with cerebellar atrophy and with or without seizures (OMIM:618056).